- Retinal detachment (HP:0000541): Separation of the inner layers of the retina (neural retina) from the pigment epithelium. Evidence: IEA. (OMIM:603221)
- High myopia (HP:0011003): A severe form of myopia with greater than -6.00 diopters. Evidence: PCS. Onset: Juvenile onset (HP:0003621). (PMID:9792869)
- Autosomal dominant inheritance (HP:0000006): A mode of inheritance that is observed for traits related to a gene encoded on one of the autosomes (i.e., the human chromosomes 1-22) in which a trait manifests in heterozygotes. In the context of medical genetics, an autosomal dominant disorder is caused when a single copy of the mutant allele is present. Males and females are affected equally, and can both transmit the disorder with a risk of 50% for each child of inheriting the mutant allele. Evidence: PCS. (PMID:9792869)
These phenotypes are associated with the disease myopia 3, autosomal dominant (OMIM:603221).